- Abnormality of the dentition (HP:0000164): Any abnormality of the teeth. Evidence: TAS. Frequency: Very frequent (HP:0040281). (ORPHA:560)
- Thick lower lip vermilion (HP:0000179): Increased thickness of the lower lip, leading to a prominent appearance of the lower lip. The height of the vermilion of the lower lip in the midline is more than 2 SD above the mean. Alternatively, an apparently increased height of the vermilion of the lower lip in the frontal view (subjective). Evidence: TAS. Frequency: Very frequent (HP:0040281). (ORPHA:560)
- Thick upper lip vermilion (HP:0000215): Height of the vermilion of the upper lip in the midline more than 2 SD above the mean. Alternatively, an apparently increased height of the vermilion of the upper lip in the frontal view (subjective). Evidence: TAS. Frequency: Very frequent (HP:0040281). (ORPHA:560)
- Brachycephaly (HP:0000248): An abnormality of skull shape characterized by a decreased anterior-posterior diameter. That is, a cephalic index greater than 81%. Alternatively, an apparently shortened anteroposterior dimension (length) of the head compared to width. Evidence: TAS. Frequency: Very frequent (HP:0040281). (ORPHA:560)
- Malar flattening (HP:0000272): Underdevelopment of the malar prominence of the jugal bone (zygomatic bone in mammals), appreciated in profile, frontal view, and/or by palpation. Evidence: TAS. Frequency: Very frequent (HP:0040281). (ORPHA:560)
- Hypertelorism (HP:0000316): Interpupillary distance more than 2 SD above the mean (alternatively, the appearance of an increased interpupillary distance or widely spaced eyes). Evidence: TAS. Frequency: Very frequent (HP:0040281). (ORPHA:560)
- Long philtrum (HP:0000343): Distance between nasal base and midline upper lip vermilion border more than 2 SD above the mean. Alternatively, an apparently increased distance between nasal base and midline upper lip vermilion border. Evidence: TAS. Frequency: Very frequent (HP:0040281). (ORPHA:560)
- Micrognathia (HP:0000347): Developmental hypoplasia of the mandible. Evidence: TAS. Frequency: Very frequent (HP:0040281). (ORPHA:560)
- Sensorineural hearing impairment (HP:0000407): A type of hearing impairment in one or both ears related to an abnormal functionality of the cochlear nerve. Evidence: TAS. Frequency: Very frequent (HP:0040281). (ORPHA:560)
- Wide nasal bridge (HP:0000431): Increased breadth of the nasal bridge (and with it, the nasal root). Evidence: TAS. Frequency: Very frequent (HP:0040281). (ORPHA:560)
- Anteverted nares (HP:0000463): Anteriorly-facing nostrils viewed with the head in the Frankfurt horizontal and the eyes of the observer level with the eyes of the subject. This gives the appearance of an upturned nose (upturned nasal tip). Evidence: TAS. Frequency: Very frequent (HP:0040281). (ORPHA:560)
- Cataract (HP:0000518): A cataract is an opacity or clouding that develops in the crystalline lens of the eye or in its capsule. Evidence: TAS. Frequency: Very frequent (HP:0040281). (ORPHA:560)
- Myopia (HP:0000545): An abnormality of refraction characterized by the ability to see objects nearby clearly, while objects in the distance appear blurry. Evidence: TAS. Frequency: Very frequent (HP:0040281). (ORPHA:560)
- Arthralgia (HP:0002829): Joint pain. Evidence: TAS. Frequency: Very frequent (HP:0040281). (ORPHA:560)
- Short nose (HP:0003196): Distance from nasion to subnasale more than two standard deviations below the mean, or alternatively, an apparently decreased length from the nasal root to the nasal tip. Evidence: TAS. Frequency: Very frequent (HP:0040281). (ORPHA:560)
- Short stature (HP:0004322): A height below that which is expected according to age and gender norms. Although there is no universally accepted definition of short stature, many refer to "short stature" as height more than 2 standard deviations below the mean for age and gender (or below the 3rd percentile for age and gender dependent norms). Evidence: TAS. Frequency: Very frequent (HP:0040281). (ORPHA:560)
- Depressed nasal bridge (HP:0005280): Posterior positioning of the nasal root in relation to the overall facial profile for age. Evidence: TAS. Frequency: Very frequent (HP:0040281). (ORPHA:560)
- Hypoplasia of the zygomatic bone (HP:0010669): Underdevelopment of the zygomatic bone. That is, a reduction in size of the zygomatic bone, including the zygomatic process of the temporal bone of the skull, which forms part of the zygomatic arch. Evidence: TAS. Frequency: Very frequent (HP:0040281). (ORPHA:560)
- Flat face (HP:0012368): Absence of concavity or convexity of the face when viewed in profile. Evidence: TAS. Frequency: Very frequent (HP:0040281). (ORPHA:560)
- Cleft palate (HP:0000175): Cleft palate is a developmental defect of the palate resulting from a failure of fusion of the palatine processes and manifesting as a separation of the roof of the mouth (soft and hard palate). Evidence: TAS. Frequency: Frequent (HP:0040282). (ORPHA:560)
- Hypoplasia of the maxilla (HP:0000327): Abnormally small dimension of the Maxilla. Usually creating a malocclusion or malalignment between the upper and lower teeth or resulting in a deficient amount of projection of the base of the nose and lower midface region. Evidence: TAS. Frequency: Frequent (HP:0040282). (ORPHA:560)
- Glaucoma (HP:0000501): Glaucoma refers loss of retinal ganglion cells in a characteristic pattern of optic neuropathy usually associated with increased intraocular pressure. Evidence: TAS. Frequency: Frequent (HP:0040282). (ORPHA:560)
- Visual impairment (HP:0000505): Visual impairment (or vision impairment) is vision loss (of a person) to such a degree as to qualify as an additional support need through a significant limitation of visual capability resulting from either disease, trauma, or congenital or degenerative conditions that cannot be corrected by conventional means, such as refractive correction, medication, or surgery. Evidence: TAS. Frequency: Frequent (HP:0040282). (ORPHA:560)
- Proptosis (HP:0000520): An eye that is protruding anterior to the plane of the face to a greater extent than is typical. Evidence: TAS. Frequency: Frequent (HP:0040282). (ORPHA:560)
- Retinal detachment (HP:0000541): Separation of the inner layers of the retina (neural retina) from the pigment epithelium. Evidence: TAS. Frequency: Frequent (HP:0040282). (ORPHA:560)
- Amblyopia (HP:0000646): Reduced visual acuity that is uncorrectable by lenses in the absence of detectable anatomic defects in the eye or visual pathways. Evidence: TAS. Frequency: Frequent (HP:0040282). (ORPHA:560)
- Hypohidrosis (HP:0000966): Abnormally diminished capacity to sweat. Evidence: TAS. Frequency: Frequent (HP:0040282). (ORPHA:560)
- Ectopia lentis (HP:0001083): Dislocation or malposition of the crystalline lens of the eye. A partial displacement (or dislocation) of the lens is described as a subluxation of the lens, while a complete displacement is termed luxation of the lens. A complete displacement occurs if the lens is completely outside the patellar fossa of the lens, either in the anterior chamber, in the vitreous, or directly on the retina. If the lens is partially displaced but still contained within the lens space, then it is termed subluxation. Evidence: TAS. Frequency: Frequent (HP:0040282). (ORPHA:560)
- Cerebral calcification (HP:0002514): The presence of calcium deposition within the cerebrum. Evidence: TAS. Frequency: Frequent (HP:0040282). (ORPHA:560)
- Thickened calvaria (HP:0002684): The presence of an abnormally thick calvaria. Evidence: TAS. Frequency: Frequent (HP:0040282). (ORPHA:560)
- Hypoplastic frontal sinuses (HP:0002738): Underdevelopment of frontal sinus. Evidence: TAS. Frequency: Frequent (HP:0040282). (ORPHA:560)
- Osteoarthritis (HP:0002758): Degeneration (wear and tear) of articular cartilage, i.e., of the joint surface. Joint degeneration may be accompanied by osteophytes (bone overgrowth), narrowing of the joint space, regions of sclerosis at the joint surface, or joint deformity. Evidence: TAS. Frequency: Frequent (HP:0040282). (ORPHA:560)
- Genu valgum (HP:0002857): The legs angle inward, such that the knees are close together and the ankles far apart. Evidence: TAS. Frequency: Frequent (HP:0040282). (ORPHA:560)
- Abnormal vitreous humor morphology (HP:0004327): Any structural anomaly of the vitreous body. Evidence: TAS. Frequency: Frequent (HP:0040282). (ORPHA:560)
- Vitreoretinopathy (HP:0007773): Ocular abnormality characterized by premature degeneration of the vitreous and the retina that may be associated with increased risk of retinal detachment. Evidence: TAS. Frequency: Frequent (HP:0040282). (ORPHA:560)
- Sparse hair (HP:0008070): Reduced density of hairs. Evidence: TAS. Frequency: Frequent (HP:0040282). (ORPHA:560)
- High palate (HP:0000218): Height of the palate more than 2 SD above the mean (objective) or palatal height at the level of the first permanent molar more than twice the height of the teeth (subjective). Evidence: TAS. Frequency: Occasional (HP:0040283). (ORPHA:560)
- Strabismus (HP:0000486): A misalignment of the eyes so that the visual axes deviate from bifoveal fixation. The classification of strabismus may be based on a number of features including the relative position of the eyes, whether the deviation is latent or manifest, intermittent or constant, concomitant or otherwise and according to the age of onset and the relevance of any associated refractive error. Evidence: TAS. Frequency: Occasional (HP:0040283). (ORPHA:560)
- Nystagmus (HP:0000639): Rhythmic, involuntary oscillations of one or both eyes related to abnormality in fixation, conjugate gaze, or vestibular mechanisms. Evidence: TAS. Frequency: Occasional (HP:0040283). (ORPHA:560)
- Sparse eyelashes (HP:0000653): Decreased density/number of eyelashes. Evidence: TAS. Frequency: Occasional (HP:0040283). (ORPHA:560)
- Frontal bossing (HP:0002007): Bilateral bulging of the lateral frontal bone prominences with relative sparing of the midline. Evidence: TAS. Frequency: Occasional (HP:0040283). (ORPHA:560)
- Sparse eyebrow (HP:0045075): Decreased density/number of eyebrow hairs. Evidence: TAS. Frequency: Occasional (HP:0040283). (ORPHA:560)
These phenotypes are associated with the disease Marshall syndrome (ORPHA:560).